Phenotypes associated with the disease Melnick-Needles syndrome (ORPHA:2484):
- Joint hypermobility (HP:0001382): The capability that a joint (or a group of joints) has to move, passively and/or actively, beyond normal limits along physiological axes. Evidence: TAS. Frequency: Frequent (HP:0040282). (ORPHA:2484)
- Delayed cranial suture closure (HP:0000270): Infants normally have two fontanels at birth, the diamond-shaped anterior fontanelle at the junction of the coronal and sagittal sutures, and the posterior fontanelle at the intersection of the occipital and parietal bones. The posterior fontanelle usually closes by the 8th week of life, and the anterior fontanel closes by the 18th month of life on average. This term applies if there is delay of closure of the fontanelles beyond the normal age. Evidence: TAS. Frequency: Very frequent (HP:0040281). (ORPHA:2484)
- Hypertelorism (HP:0000316): Interpupillary distance more than 2 SD above the mean (alternatively, the appearance of an increased interpupillary distance or widely spaced eyes). Evidence: TAS. Frequency: Very frequent (HP:0040281). (ORPHA:2484)
- Prominent supraorbital ridges (HP:0000336): Greater than average forward and/or lateral protrusion of the supraorbital portion of the frontal bones. Evidence: TAS. Frequency: Very frequent (HP:0040281). (ORPHA:2484)
- Micrognathia (HP:0000347): Developmental hypoplasia of the mandible. Evidence: TAS. Frequency: Very frequent (HP:0040281). (ORPHA:2484)
- Proptosis (HP:0000520): An eye that is protruding anterior to the plane of the face to a greater extent than is typical. Evidence: TAS. Frequency: Very frequent (HP:0040281). (ORPHA:2484)
- Narrow chest (HP:0000774): Reduced width of the chest from side to side, associated with a reduced distance from the sternal notch to the tip of the shoulder. Evidence: TAS. Frequency: Very frequent (HP:0040281). (ORPHA:2484)
- Abnormal metaphysis morphology (HP:0000944): An abnormality of one or more metaphysis, i.e., of the somewhat wider portion of a long bone that is adjacent to the epiphyseal growth plate and grows during childhood. Evidence: TAS. Frequency: Very frequent (HP:0040281). (ORPHA:2484)
- Abnormal cortical bone morphology (HP:0003103): An abnormality of compact bone (also known as cortical bone), which forms the dense surface of bones. Evidence: TAS. Frequency: Very frequent (HP:0040281). (ORPHA:2484)
- Short stature (HP:0004322): A height below that which is expected according to age and gender norms. Although there is no universally accepted definition of short stature, many refer to "short stature" as height more than 2 standard deviations below the mean for age and gender (or below the 3rd percentile for age and gender dependent norms). Evidence: TAS. Frequency: Very frequent (HP:0040281). (ORPHA:2484)
- Bowing of the long bones (HP:0006487): A bending or abnormal curvature of a long bone. Evidence: TAS. Frequency: Very frequent (HP:0040281). (ORPHA:2484)
- Short thorax (HP:0010306): Reduced inferior to superior extent of the thorax. Evidence: TAS. Frequency: Very frequent (HP:0040281). (ORPHA:2484)
- Vesicoureteral reflux (HP:0000076): Abnormal (retrograde) movement of urine from the bladder into ureters or kidneys related to inadequacy of the valvular mechanism at the ureterovesicular junction or other causes. Evidence: TAS. Frequency: Frequent (HP:0040282). (ORPHA:2484)
- Hydronephrosis (HP:0000126): Severe distention of the kidney with dilation of the renal pelvis and calices. Evidence: TAS. Frequency: Frequent (HP:0040282). (ORPHA:2484)
- Full cheeks (HP:0000293): Increased prominence or roundness of soft tissues between zygomata and mandible. Evidence: TAS. Frequency: Frequent (HP:0040282). (ORPHA:2484)
- Facial asymmetry (HP:0000324): An abnormal difference between the left and right sides of the face. Evidence: TAS. Frequency: Frequent (HP:0040282). (ORPHA:2484)
- Hearing impairment (HP:0000365): A decreased magnitude of the sensory perception of sound. Evidence: TAS. Frequency: Frequent (HP:0040282). (ORPHA:2484)
- Delayed eruption of teeth (HP:0000684): Delayed tooth eruption, which can be defined as tooth eruption more than 2 SD beyond the mean eruption age. Evidence: TAS. Frequency: Frequent (HP:0040282). (ORPHA:2484)
- Tooth malposition (HP:0000692): Abnormal alignment, positioning, or spacing of the teeth, i.e., misaligned teeth. Evidence: TAS. Frequency: Frequent (HP:0040282). (ORPHA:2484)
- Abnormal rib morphology (HP:0000772): An anomaly of the rib. Evidence: TAS. Frequency: Frequent (HP:0040282). (ORPHA:2484)
- Short clavicles (HP:0000894): Reduced length of the clavicles. Evidence: TAS. Frequency: Frequent (HP:0040282). (ORPHA:2484)
- Abnormal cardiac septum morphology (HP:0001671): An anomaly of the intra-atrial or intraventricular septum. Evidence: TAS. Frequency: Frequent (HP:0040282). (ORPHA:2484)
- Frontal bossing (HP:0002007): Bilateral bulging of the lateral frontal bone prominences with relative sparing of the midline. Evidence: TAS. Frequency: Frequent (HP:0040282). (ORPHA:2484)
- Recurrent respiratory infections (HP:0002205): An increased susceptibility to respiratory infections as manifested by a history of recurrent respiratory infections. Evidence: TAS. Frequency: Frequent (HP:0040282). (ORPHA:2484)
- Scoliosis (HP:0002650): The presence of an abnormal lateral curvature of the spine. Evidence: TAS. Frequency: Frequent (HP:0040282). (ORPHA:2484)
- Coxa valga (HP:0002673): Coxa valga is a deformity of the hip in which the angle between the femoral shaft and the femoral neck is increased compared to age-adjusted values (about 150 degrees in newborns gradually reducing to 120-130 degrees in adults). Evidence: TAS. Frequency: Frequent (HP:0040282). (ORPHA:2484)
- Hip dislocation (HP:0002827): Displacement of the femur from its normal location in the hip joint. Evidence: TAS. Frequency: Frequent (HP:0040282). (ORPHA:2484)
- Anisospondyly (HP:0002879): Abnormally increased variability of the size of the vertebral bodies. Evidence: TAS. Frequency: Frequent (HP:0040282). (ORPHA:2484)
- Abnormal pubic bone morphology (HP:0003172): An anomaly of the the pubic bone, i.e., of the ventral and anterior of the three principal components (pubis, ilium, ischium) of the hip bone. Evidence: TAS. Frequency: Frequent (HP:0040282). (ORPHA:2484)
- Craniofacial hyperostosis (HP:0004493): Excessive growth of the craniofacial bones. Evidence: TAS. Frequency: Frequent (HP:0040282). (ORPHA:2484)
- Osteolytic defects of the phalanges of the hand (HP:0009771): Dissolution or degeneration of bone tissue of the phalanges of the hand. Evidence: TAS. Frequency: Frequent (HP:0040282). (ORPHA:2484)
- Short distal phalanx of finger (HP:0009882): Short distance from the end of the finger to the most distal interphalangeal crease or the distal interphalangeal joint flexion point. That is, hypoplasia of one or more of the distal phalanx of finger. Evidence: TAS. Frequency: Frequent (HP:0040282). (ORPHA:2484)
- Cone-shaped epiphyses of the phalanges of the hand (HP:0010230): A cone-shaped appearance of the epiphyses of the fingers of the hand, producing a 'ball-in-a-socket' appearance. The related entity 'angel-shaped' epiphysis refers to a pronounced cone-shaped epiphysis in combination with a pseudoepiphysis at the distal end of a phalanx. Evidence: TAS. Frequency: Frequent (HP:0040282). (ORPHA:2484)
- Omphalocele (HP:0001539): A midline anterior incomplete closure of the abdominal wall in which there is herniation of the abdominal viscera into the base of the abdominal cord. Evidence: TAS. Frequency: Occasional (HP:0040283). (ORPHA:2484)
- Respiratory insufficiency (HP:0002093). Evidence: TAS. Frequency: Occasional (HP:0040283). (ORPHA:2484)